- Strabismus (HP:0000486): A misalignment of the eyes so that the visual axes deviate from bifoveal fixation. The classification of strabismus may be based on a number of features including the relative position of the eyes, whether the deviation is latent or manifest, intermittent or constant, concomitant or otherwise and according to the age of onset and the relevance of any associated refractive error. Evidence: PCS. (PMID:26365382)
- Trigonocephaly (HP:0000243): Wedge-shaped, or triangular head, with the apex of the triangle at the midline of the forehead and the base of the triangle at the occiput. Evidence: PCS. Frequency: 1/7. (PMID:26365382)
- Apraxia (HP:0002186): A defect in the understanding of complex motor commands and in the execution of certain learned movements, i.e., deficits in the cognitive components of learned movements. Evidence: PCS. Frequency: 3/7. (PMID:26365382)
- Seizure (HP:0001250): A seizure is an intermittent abnormality of nervous system physiology characterized by a transient occurrence of signs and/or symptoms due to abnormal excessive or synchronous neuronal activity in the brain. Evidence: PCS. Frequency: 5/7. (PMID:26365382)
- Hypotonia (HP:0001252): Hypotonia is an abnormally low muscle tone (the amount of tension or resistance to movement in a muscle). Even when relaxed, muscles have a continuous and passive partial contraction which provides some resistance to passive stretching. Hypotonia thus manifests as diminished resistance to passive stretching. Hypotonia is not the same as muscle weakness, although the two conditions can co-exist. Evidence: PCS. Frequency: 4/7. (PMID:26365382)
- Generalized hypotonia (HP:0001290): Generalized muscular hypotonia (abnormally low muscle tone). Evidence: TAS. (OMIM:616863)
- Aggressive behavior (HP:0000718): Behavior or an act aimed at harming a person, animal, or physical property (e.g., acts of physical violence; shouting, swearing, and using harsh language; slashing someone's tires). Evidence: PCS. Frequency: 5/7. (PMID:26365382)
- Large fontanelles (HP:0000239): In newborns, the two frontal bones, two parietal bones, and one occipital bone are joined by fibrous sutures, which form a small posterior fontanelle, and a larger, diamond-shaped anterior fontanelle. These regions allow for the skull to pass the birth canal and for later growth. The fontanelles gradually ossify, whereby the posterior fontanelle usually closes by eight weeks and the anterior fontanelle by the 9th to 16th month of age. Large fontanelles are diagnosed if the fontanelles are larger than age-dependent norms. Evidence: PCS. Frequency: 1/7. (PMID:26365382)
- Hallux valgus (HP:0001822): Lateral deviation of the great toe (i.e., in the direction of the little toe). Evidence: PCS. Frequency: 1/7. (PMID:26365382)
- Intellectual disability (HP:0001249): The term intellectual disability or intellectual developmental disorder is used to describe significantly sub-average intellectual and adaptive functioning based on clinical assessment and as measured by individually administered, appropriately normed, standardized and validated tests of intellectual functioning and adaptive behavior, with onset during the developmental period from infancy through adolescence. Evidence: PCS. Frequency: 7/7. (PMID:26365382)
- Micropenis (HP:0000054): Abnormally small penis. At birth, the normal penis is about 3 cm (stretched length from pubic tubercle to tip of penis) with micropenis less than 2.0-2.5 cm. Evidence: TAS. (OMIM:616863)
- Delayed speech and language development (HP:0000750): A degree of language development that is significantly below the norm for a child of a specified age. Evidence: PCS. Frequency: 6/6. (PMID:26365382)
- Absent speech (HP:0001344): Complete lack of development of speech and language abilities. Evidence: IEA. (OMIM:616863)
- Perseverative thought (HP:0030223): The repetitive production of the same response to different commands. Evidence: PCS. (PMID:26365382)
- Delayed cranial suture closure (HP:0000270): Infants normally have two fontanels at birth, the diamond-shaped anterior fontanelle at the junction of the coronal and sagittal sutures, and the posterior fontanelle at the intersection of the occipital and parietal bones. The posterior fontanelle usually closes by the 8th week of life, and the anterior fontanel closes by the 18th month of life on average. This term applies if there is delay of closure of the fontanelles beyond the normal age. Evidence: PCS. Frequency: 1/7. (PMID:26365382)
- Global developmental delay (HP:0001263): A delay in the achievement of motor or mental milestones in the domains of development of a child, including motor skills, speech and language, cognitive skills, and social and emotional skills. This term should only be used to describe children younger than five years of age. Evidence: PCS. Frequency: 7/7. (PMID:26365382)
- Central sleep apnea (HP:0010536): Sleep apnea results from a temporary loss of the central drive to the muscles responsible for breathing. Evidence: PCS. (PMID:26365382)
- Premature adrenarche (HP:0012412): Onset of adrenarche at an earlier age than usual. Evidence: PCS. Frequency: 1/2. (PMID:26365382)
- Autistic behavior (HP:0000729): Persistent deficits in social interaction and communication and interaction as well as a markedly restricted repertoire of activity and interest as well as repetitive patterns of behavior. Evidence: PCS. Frequency: 5/7. (PMID:26365382)
- Speech apraxia (HP:0011098): A type of apraxia that is characterized by difficulty or inability to execute speech movements because of problems with coordination and motor problems, leading to incorrect articulation. An increase of errors with increasing word and phrase length may occur. Evidence: TAS. (OMIM:616863)
- Abnormal facial shape (HP:0001999): An abnormal morphology (form) of the face or its components. Evidence: TAS. Frequency: Occasional (HP:0040283). (OMIM:616863)
- Clinodactyly of the 5th finger (HP:0004209): Clinodactyly refers to a bending or curvature of the fifth finger in the radial direction (i.e., towards the 4th finger). Evidence: PCS. Frequency: 1/7. (PMID:26365382)
- Cryptorchidism (HP:0000028): Testis in inguinal canal. That is, absence of one or both testes from the scrotum owing to failure of the testis or testes to descend through the inguinal canal to the scrotum. Evidence: PCS. Frequency: 3/4. (PMID:26365382)
- Low-set ears (HP:0000369): Upper insertion of the ear to the scalp below an imaginary horizontal line drawn between the inner canthi of the eye and extending posteriorly to the ear. Evidence: PCS. Frequency: 1/7. (PMID:26365382)
- Autosomal dominant inheritance (HP:0000006): A mode of inheritance that is observed for traits related to a gene encoded on one of the autosomes (i.e., the human chromosomes 1-22) in which a trait manifests in heterozygotes. In the context of medical genetics, an autosomal dominant disorder is caused when a single copy of the mutant allele is present. Males and females are affected equally, and can both transmit the disorder with a risk of 50% for each child of inheriting the mutant allele. Evidence: PCS. (PMID:26365382)
These phenotypes are associated with the disease Hao-Fountain syndrome due to USP7 mutation (OMIM:616863).